- Chronic rhinitis (HP:0002257): Chronic inflammation of the nasal mucosa. Evidence: PCS. Frequency: 10/12. (PMID:23993197)
- Short stature (HP:0004322): A height below that which is expected according to age and gender norms. Although there is no universally accepted definition of short stature, many refer to "short stature" as height more than 2 standard deviations below the mean for age and gender (or below the 3rd percentile for age and gender dependent norms). Evidence: TAS. (OMIM:612649)
- Bronchiectasis (HP:0002110): Persistent abnormal dilatation of the bronchi owing to localized and irreversible destruction and widening of the large airways. Evidence: PCS. Frequency: 9/12. (PMID:23993197)
- Decreased nasal nitric oxide (HP:0033036): Reduced level of nasal nitric oxide (nNO). Current American Thoracic Society/European Respiratory Society (ATS/ERS) guidelines for nNO measurements recommend air aspiration via a nasal probe while the subject exhales through the mouth against resistance in order to maintain velum closure. Evidence: PCS. Frequency: 4/5. (PMID:23993197)
- Reduced sperm motility (HP:0012207): An abnormal reduction in the mobility of ejaculated sperm. Evidence: PCS. Frequency: 1/1. (PMID:23993197)
- Recurrent sinusitis (HP:0011108): A recurrent form of sinusitis. Evidence: PCS. Frequency: 10/12. (PMID:23993197)
- Ciliary dyskinesia (HP:0012265): A deviation from the normally well coordinated pattern of intracellular and intercellular synchrony of motile cilia. Dyskinetic cilia usually beat out of synchrony relative to neighboring cilia. Evidence: PCS. (PMID:23993197)
- Abnormal central microtubular pair morphology of respiratory motile cilia (HP:0012260): A structural anomaly of the two central microtubules of motile cilia with a 9+2 microtubuluar configuration. Evidence: PCS. Frequency: 10/10. (PMID:23993197)
- Immotile cilia (HP:0012263). Evidence: PCS. Frequency: 1/1. (PMID:23993197)
- Autosomal recessive inheritance (HP:0000007): A mode of inheritance that is observed for traits related to a gene encoded on one of the autosomes (i.e., the human chromosomes 1-22) in which a trait manifests in individuals with two pathogenic alleles, either homozygotes (two copies of the same mutant allele) or compound heterozygotes (whereby each copy of a gene has a distinct mutant allele). Evidence: PCS. (PMID:23993197)
- Recurrent respiratory infections (HP:0002205): An increased susceptibility to respiratory infections as manifested by a history of recurrent respiratory infections. Evidence: TAS. (OMIM:612649)
- Neonatal respiratory distress (HP:0002643): Respiratory difficulty as newborn. Evidence: PCS. Frequency: 4/12. Onset: Neonatal onset (HP:0003623). (PMID:23993197)
- Exercise intolerance (HP:0003546): A functional motor deficit where individuals whose responses to the challenges of exercise fail to achieve levels considered normal for their age and gender. Evidence: TAS. (OMIM:612649)
- Chronic bronchitis (HP:0004469): Chronic inflammation of the bronchi. Evidence: PCS. Frequency: 3/12. (PMID:23993197)
These phenotypes are associated with the disease primary ciliary dyskinesia 11 (OMIM:612649).